Phenotypes associated with the disease epidermolysis bullosa simplex 4, localized or generalized intermediate, autosomal recessive (OMIM:615028):
- Fragile skin (HP:0001030): Skin that splits easily with minimal injury. Evidence: PCS. Frequency: 3/3. (PMID:23176819)
- Childhood onset (HP:0011463): Onset of disease at the age of between 1 and 5 years. Evidence: PCS. Frequency: 3/3. (PMID:23176819)
- Abnormal blistering of the skin (HP:0008066): The presence of one or more bullae on the skin, defined as fluid-filled blisters more than 5 mm in diameter with thin walls. Evidence: PCS. Frequency: 3/3. (PMID:23176819)
- Epidermal acanthosis (HP:0025092): Diffuse hypertrophy or thickening of the stratum spinosum of the epidermis (prickle cell layer of the skin). Evidence: PCS. Frequency: 1/1. (PMID:23176819)
- Autosomal recessive inheritance (HP:0000007): A mode of inheritance that is observed for traits related to a gene encoded on one of the autosomes (i.e., the human chromosomes 1-22) in which a trait manifests in individuals with two pathogenic alleles, either homozygotes (two copies of the same mutant allele) or compound heterozygotes (whereby each copy of a gene has a distinct mutant allele). Evidence: PCS. (PMID:23176819)
- Hyperkeratosis (HP:0000962): Hyperkeratosis is a histopathological term defining a thickened stratum corneum and may be present in many different skin conditions, with many possible overlaps. Hyperkeratosis refers to the increased thickness of the stratum corneum, the outer layer of the skin. Hyperkeratosis is subclassified as orthokeratotic or parakeratotic. Orthokeratotic hyperkeratosis refers to the thickening of the keratin layer with preserved keratinocyte maturation, while parakeratotic hyperkeratosis shows retained nuclei as a sign of delayed maturation of keratinocytes. Evidence: PCS. Frequency: 1/1. (PMID:23176819)